- Short stature (HP:0004322): A height below that which is expected according to age and gender norms. Although there is no universally accepted definition of short stature, many refer to "short stature" as height more than 2 standard deviations below the mean for age and gender (or below the 3rd percentile for age and gender dependent norms). Evidence: TAS. (OMIM:300498)
- X-linked recessive inheritance (HP:0001419): A mode of inheritance that is observed for recessive traits related to a gene encoded on the X chromosome. In the context of medical genetics, X-linked recessive disorders manifest in males (who have one copy of the X chromosome and are thus hemizygotes), but generally not in female heterozygotes who have one mutant and one normal allele. Evidence: TAS. (PMID:15121780)
- Prominent nasal bridge (HP:0000426): Anterior positioning of the nasal root in comparison to the usual positioning for age. Evidence: TAS. (OMIM:300498)
- High palate (HP:0000218): Height of the palate more than 2 SD above the mean (objective) or palatal height at the level of the first permanent molar more than twice the height of the teeth (subjective). Evidence: TAS. (OMIM:300498)
- Macrotia (HP:0000400): Median longitudinal ear length greater than two standard deviations above the mean and median ear width greater than two standard deviations above the mean (objective); or, apparent increase in length and width of the pinna (subjective). Evidence: TAS. (PMID:15121780)
- Protruding ear (HP:0000411): Angle formed by the plane of the ear and the mastoid bone greater than the 97th centile for age (objective); or, outer edge of the helix more than 2 cm from the mastoid at the point of maximum distance (objective). Evidence: TAS. (OMIM:300498)
- Intellectual disability (HP:0001249): The term intellectual disability or intellectual developmental disorder is used to describe significantly sub-average intellectual and adaptive functioning based on clinical assessment and as measured by individually administered, appropriately normed, standardized and validated tests of intellectual functioning and adaptive behavior, with onset during the developmental period from infancy through adolescence. Evidence: TAS. (PMID:15121780)
These phenotypes are associated with the disease intellectual disability, X-linked 45 (OMIM:300498).